- Arthralgia (HP:0002829): Joint pain. Evidence: TAS. Frequency: Obligate (HP:0040280). (ORPHA:247353)
- Elevated erythrocyte sedimentation rate (HP:0003565): An increased erythrocyte sedimentation rate (ESR). The ESR is a test that measures the distance that erythrocytes have fallen after one hour in a vertical column of anticoagulated blood under the influence of gravity. The ESR is a nonspecific finding. An elevation may indicate inflammation or may be caused by any condition that elevates fibrinogen. Evidence: TAS. Frequency: Obligate (HP:0040280). (ORPHA:247353)
- Erythematous plaque (HP:0025474): A plaque (a solid, raised, plateau-like (flat-topped) lesion greater than 1 cm in diameter) with a red or reddish color often associated with inflammation or irritation. Evidence: TAS. Frequency: Obligate (HP:0040280). (ORPHA:247353)
- Pustule (HP:0200039): A small elevation of the skin containing cloudy or purulent material usually consisting of necrotic inflammatory cells. Evidence: TAS. Frequency: Obligate (HP:0040280). (ORPHA:247353)
- Erythroderma (HP:0001019): An inflammatory exfoliative dermatosis involving nearly all of the surface of the skin. Erythroderma develops suddenly. A patchy erythema may generalize and spread to affect most of the skin. Scaling may appear in 2-6 days and be accompanied by hot, red, dry skin, malaise, and fever. Evidence: TAS. Frequency: Very frequent (HP:0040281). (ORPHA:247353)
- Abnormal nail morphology (HP:0001597): Abnormal structure or appearance of the nail. Evidence: TAS. Frequency: Very frequent (HP:0040281). (ORPHA:247353)
- Pain (HP:0012531): An unpleasant sensory and emotional experience associated with actual or potential tissue damage, or described in terms of such damage. Evidence: TAS. Frequency: Very frequent (HP:0040281). (ORPHA:247353)
- Arthritis (HP:0001369): Inflammation of a joint. Evidence: TAS. Frequency: Frequent (HP:0040282). (ORPHA:247353)
- Fever (HP:0001945): Body temperature elevated above the normal range. Evidence: TAS. Frequency: Frequent (HP:0040282). (ORPHA:247353)
- Increased total leukocyte count (HP:0001974): An abnormal increase in the number of leukocytes in the blood. Evidence: TAS. Frequency: Frequent (HP:0040282). (ORPHA:247353)
- Elevated circulating C-reactive protein concentration (HP:0011227): The concentration of C-reactive protein in the blood circulation is above the upper limit of normal. Evidence: TAS. Frequency: Frequent (HP:0040282). (ORPHA:247353)
- Fatigue (HP:0012378): A subjective feeling of tiredness characterized by a lack of energy and motivation. Evidence: TAS. Frequency: Frequent (HP:0040282). (ORPHA:247353)
- Geographic tongue (HP:0025252): An anomaly of the tongue characterized by loss (atrophy) of filiform papillae of the tongue, leaving areas of erythema (redness), surrounded by a serpiginous, white, hyperkeratotic border. The name geographic tongue refers to an appearance that is said to be similar to a map. Evidence: TAS. Frequency: Frequent (HP:0040282). (ORPHA:247353)
- Overweight (HP:0025502): Increased body weight with a body mass index of 25-29.9 kg per square meter. Evidence: TAS. Frequency: Frequent (HP:0040282). (ORPHA:247353)
- Cheilitis (HP:0100825): Inflammation of the lip. Evidence: TAS. Frequency: Frequent (HP:0040282). (ORPHA:247353)
- Renal insufficiency (HP:0000083): A reduction in the level of performance of the kidneys in areas of function comprising the concentration of urine, removal of wastes, the maintenance of electrolyte balance, homeostasis of blood pressure, and calcium metabolism. Evidence: TAS. Frequency: Occasional (HP:0040283). (ORPHA:247353)
- Obesity (HP:0001513): Accumulation of substantial excess body fat. Evidence: TAS. Frequency: Occasional (HP:0040283). (ORPHA:247353)
- Decreased total lymphocyte count (HP:0001888): A reduced number of lymphocytes in the blood. Evidence: TAS. Frequency: Occasional (HP:0040283). (ORPHA:247353)
- Hypocalcemia (HP:0002901): The concentration of calcium in the blood circulation is below the lower limit of normal. Evidence: TAS. Frequency: Occasional (HP:0040283). (ORPHA:247353)
- Hyponatremia (HP:0002902): The concentration of sodium in the blood circulation is below the lower limit of normal. Evidence: TAS. Frequency: Occasional (HP:0040283). (ORPHA:247353)
- Elevated circulating hepatic transaminase concentration (HP:0002910): Elevations of the levels of SGOT and SGPT in the serum. SGOT (serum glutamic oxaloacetic transaminase) and SGPT (serum glutamic pyruvic transaminase) are transaminases primarily found in the liver and heart and are released into the bloodstream as the result of liver or heart damage. SGOT and SGPT are used clinically mainly as markers of liver damage. Evidence: TAS. Frequency: Occasional (HP:0040283). (ORPHA:247353)
- Hypoalbuminemia (HP:0003073): The concentration of albumin in the blood circulation is below the lower limit of normal. Evidence: TAS. Frequency: Occasional (HP:0040283). (ORPHA:247353)
- Pedal edema (HP:0010741): An abnormal accumulation of excess fluid in the lower extremity resulting in swelling of the feet and extending upward to the lower leg. Evidence: TAS. Frequency: Occasional (HP:0040283). (ORPHA:247353)
- Palmoplantar pustulosis (HP:0100847): A chronic, relapsing, pustular eruption that is localized to the palms and soles. Evidence: TAS. Frequency: Occasional (HP:0040283). (ORPHA:247353)
- Uveitis (HP:0000554): Inflammation of one or all portions of the uveal tract. Evidence: TAS. Frequency: Very rare (HP:0040284). (ORPHA:247353)
- Congestive heart failure (HP:0001635): The presence of an abnormality of cardiac function that is responsible for the failure of the heart to pump blood at a rate that is commensurate with the needs of the tissues or a state in which abnormally elevated filling pressures are required for the heart to do so. Heart failure is frequently related to a defect in myocardial contraction. Evidence: TAS. Frequency: Very rare (HP:0040284). (ORPHA:247353)
- Sepsis (HP:0100806): Sepsis is defined as life-threatening organ dysfunction caused by a dysregulated host response to infection. Evidence: TAS. Frequency: Very rare (HP:0040284). (ORPHA:247353)
These phenotypes are associated with the disease Generalized pustular psoriasis (ORPHA:247353).